Phenotypes associated with the disease ceroid lipofuscinosis, neuronal, 4 (Kufs type) (OMIM:162350):
- Bilateral tonic-clonic seizure (HP:0002069): A bilateral tonic-clonic seizure is a seizure defined by a tonic (bilateral increased tone, lasting seconds to minutes) and then a clonic (bilateral sustained rhythmic jerking) phase. Evidence: PCS. Frequency: 1/1. Onset: Young adult onset (HP:0011462). (PMID:21820099)
- Visual hallucination (HP:0002367): Visual perception in the absence of a visual stimulus. Evidence: TAS. (OMIM:162350)
- Parkinsonism (HP:0001300): Characteristic neurologic anomaly resulting from degeneration of dopamine-generating cells in the substantia nigra, a region of the midbrain, characterized clinically by shaking, rigidity, slowness of movement and difficulty with walking and gait. Evidence: IEA. (OMIM:162350)
- Seizure (HP:0001250): A seizure is an intermittent abnormality of nervous system physiology characterized by a transient occurrence of signs and/or symptoms due to abnormal excessive or synchronous neuronal activity in the brain. Evidence: IEA. (OMIM:162350)
- Increased neuronal autofluorescent lipopigment (HP:0002074): Lipofuscin, a generic term applied to autofluorescent lipopigment, is a mixture of protein and lipid that accumulates in most aging cells, particularly those involved in high lipid turnover (e.g., the adrenal medulla) or phagocytosis of other cell types (e g., the retinal pigment epithelium or RPE; macrophage). This term pertains if there is an increase in the neuronal accumulation of lipofuscin (also known as autofluorescent lipoprotein) more than expected for the age of the patient. Evidence: IEA. (OMIM:162350)
- Ataxia (HP:0001251): Ataxia refers to impaired coordination of voluntary muscle movement. Cerebellar ataxia refers to ataxia due to dysfunction of the cerebellum. This causes a variety of elementary neurological deficits including asynergy (lack of coordination between muscles, limbs and joints), dysmetria (lack of ability to judge distances that can lead to under- or overshoot in grasping movements), and dysdiadochokinesia (inability to perform rapid movements requiring antagonizing muscle groups to be switched on and off repeatedly). Evidence: IEA. (OMIM:162350)
- Myoclonic seizure (HP:0032794): A myoclonic seizure is a type of motor seizure characterized by sudden, brief (<100 ms) involuntary single or multiple contraction of muscles or muscle groups of variable topography (axial, proximal limb, distal). Myoclonus is less regularly repetitive and less sustained than is clonus. Evidence: PCS. Frequency: 1/1. Onset: Young adult onset (HP:0011462). (PMID:21820099)
- Abnormality of extrapyramidal motor function (HP:0002071): A neurological condition related to lesions of the basal ganglia leading to typical abnormalities including akinesia (inability to initiate changes in activity and perform volitional movements rapidly and easily), muscular rigidity (continuous contraction of muscles with constant resistance to passive movement), chorea (widespread arrhythmic movements of a forcible, rapid, jerky, and restless nature), athetosis (inability to sustain the muscles of the fingers, toes, or other group of muscles in a fixed position), and akathisia (inability to remain motionless). Evidence: IEA. (OMIM:162350)
- Depression (HP:0000716): Frequently experiencing feelings of being down, miserable, and/or hopeless; struggling to recover from these moods; having a pessimistic outlook on the future; feeling a pervasive sense of shame; having a low self-worth; experiencing thoughts of suicide and engaging in suicidal behavior. Evidence: PCS. Frequency: 1/1. (PMID:21820099)
- Dementia (HP:0000726): A loss of global cognitive ability of sufficient amount to interfere with normal social or occupational function. Dementia represents a loss of previously present cognitive abilities, generally in adults, and can affect memory, thinking, language, judgment, and behavior. Evidence: PCS. Frequency: 1/1. (PMID:21820099)
- Young adult onset (HP:0011462): Onset of disease at the age of between 16 and 40 years. Evidence: PCS. Frequency: 1/1. (PMID:21820099)
- Abnormal cerebellum morphology (HP:0001317): Any structural abnormality of the cerebellum. Evidence: IEA. (OMIM:162350)
- Fingerprint intracellular accumulation of autofluorescent lipopigment storage material (HP:0003208): An intracellular accumulation of autofluorescent lipopigment storage material in a trabecular or fingerprint-like pattern. Evidence: IEA. (OMIM:162350)
- Auditory hallucination (HP:0008765): Perception of sounds without auditory stimulus. Evidence: TAS. (OMIM:162350)
- Vascular granular osmiophilic material deposition (HP:0003657): Accumulation of granular osmiophilic material in blood vessel walls. Osmiophilic material becomes black upon staining with osmium tetroxide. Deposition of granular osmiophilic material (GOM) is the vascular pathological hallmark of CADASIL, which is the most prevalent hereditary small vessel disease and is caused by missense mutations in the NOTCH3 gene. GOM have been shown to contain NOTCH3 ectodomain (NOTCH3ECD) and extracellular matrix proteins, and can be visualized ultrastructurally in the tunica media of small arteries and capillaries. These electron dense GOM deposits are located in the basement membrane of mural cells, i.e. vascular smooth muscle cells and pericytes. In both manifest and pre-manifest CADASIL patients, GOM deposits are present not only in brain vessels, but also in vessels of other organs, such as the skin. Evidence: PCS. Frequency: 1/1. (PMID:21820099)
- Rectilinear intracellular accumulation of autofluorescent lipopigment storage material (HP:0003226): An intracellular accumulation of autofluorescent lipopigment storage material in a straight or rectilinear pattern. Evidence: IEA. (OMIM:162350)
- Autosomal dominant inheritance (HP:0000006): A mode of inheritance that is observed for traits related to a gene encoded on one of the autosomes (i.e., the human chromosomes 1-22) in which a trait manifests in heterozygotes. In the context of medical genetics, an autosomal dominant disorder is caused when a single copy of the mutant allele is present. Males and females are affected equally, and can both transmit the disorder with a risk of 50% for each child of inheriting the mutant allele. Evidence: PCS. (PMID:21820099)
- Rapidly progressive (HP:0003678): Applies to a disease manifestation that quickly increases in scope or severity over the course of time. Evidence: IEA. (OMIM:162350)
- Myoclonus (HP:0001336): Very brief, involuntary random muscular contractions occurring at rest, in response to sensory stimuli, or accompanying voluntary movements. Evidence: IEA. (OMIM:162350)
- Curvilinear intracellular accumulation of autofluorescent lipopigment storage material (HP:0003205): An intracellular accumulation of autofluorescent lipopigment storage material in a curved pattern. Evidence: IEA. (OMIM:162350)